- Perifolliculitis (HP:0012322): Inflammation surrounding hair follicles. Evidence: TAS. (OMIM:613737)
- Acne inversa (HP:0040154): A chronic skin condition involving the inflammation of the apocrine sweat glands, forming pimple-like bumps known as abscesses. Evidence: PCS. (PMID:20929727)
- Chronic furunculosis (HP:0011132): A furuncle (boil) is a skin infection involving an entire hair follicle and nearby skin tissue. Chronic furunculosis refers to recurrent episodes of furuncles, often caused by recurrent staphylococcus infection. Evidence: TAS. (OMIM:613737)
- Recurrent cutaneous abscess formation (HP:0100838): An increased susceptibility to cutaneous abscess formation, as manifested by a medical history of recurrent cutaneous abscesses. Evidence: PCS. (PMID:20929727)
- Autosomal dominant inheritance (HP:0000006): A mode of inheritance that is observed for traits related to a gene encoded on one of the autosomes (i.e., the human chromosomes 1-22) in which a trait manifests in heterozygotes. In the context of medical genetics, an autosomal dominant disorder is caused when a single copy of the mutant allele is present. Males and females are affected equally, and can both transmit the disorder with a risk of 50% for each child of inheriting the mutant allele. Evidence: PCS. (PMID:20929727)
These phenotypes are associated with the disease acne inversa, familial, 3 (OMIM:613737).